Phenotypes associated with the disease Mowat-Wilson syndrome due to a ZEB2 point mutation (ORPHA:261552):
- Intellectual disability (HP:0001249): The term intellectual disability or intellectual developmental disorder is used to describe significantly sub-average intellectual and adaptive functioning based on clinical assessment and as measured by individually administered, appropriately normed, standardized and validated tests of intellectual functioning and adaptive behavior, with onset during the developmental period from infancy through adolescence. Evidence: TAS. Frequency: Very frequent (HP:0040281). (ORPHA:261552)
- Absent speech (HP:0001344): Complete lack of development of speech and language abilities. Evidence: TAS. Frequency: Very frequent (HP:0040281). (ORPHA:261552)
- Abnormal facial shape (HP:0001999): An abnormal morphology (form) of the face or its components. Evidence: TAS. Frequency: Very frequent (HP:0040281). (ORPHA:261552)
- Expressive language delay (HP:0002474): A delay in the acquisition of the ability to use language to communicate needs, wishes, or thoughts. Evidence: TAS. Frequency: Very frequent (HP:0040281). (ORPHA:261552)
- Happy demeanor (HP:0040082): A conspicuously happy disposition, characterized by frequent smiling and laughing, which may be contextually inappropriate or unrelated to the situation. Evidence: TAS. Frequency: Very frequent (HP:0040281). (ORPHA:261552)
- Urinary incontinence (HP:0000020): Loss of the ability to control the urinary bladder leading to involuntary urination. Evidence: TAS. Frequency: Frequent (HP:0040282). (ORPHA:261552)
- Cryptorchidism (HP:0000028): Testis in inguinal canal. That is, absence of one or both testes from the scrotum owing to failure of the testis or testes to descend through the inguinal canal to the scrotum. Evidence: TAS. Frequency: Frequent (HP:0040282). (ORPHA:261552)
- Hypospadias (HP:0000047): Abnormal position of urethral meatus on the ventral penile shaft (underside) characterized by displacement of the urethral meatus from the tip of the glans penis to the ventral surface of the penis, scrotum, or perineum. Evidence: TAS. Frequency: Frequent (HP:0040282). (ORPHA:261552)
- Abnormality of the genitourinary system (HP:0000119): The presence of any abnormality of the genitourinary system. Evidence: TAS. Frequency: Frequent (HP:0040282). (ORPHA:261552)
- Thick lower lip vermilion (HP:0000179): Increased thickness of the lower lip, leading to a prominent appearance of the lower lip. The height of the vermilion of the lower lip in the midline is more than 2 SD above the mean. Alternatively, an apparently increased height of the vermilion of the lower lip in the frontal view (subjective). Evidence: TAS. Frequency: Frequent (HP:0040282). (ORPHA:261552)
- Open mouth (HP:0000194): A facial appearance characterized by a permanently or nearly permanently opened mouth. Evidence: TAS. Frequency: Frequent (HP:0040282). (ORPHA:261552)
- Mandibular prognathia (HP:0000303): Abnormal prominence of the chin related to increased length of the mandible. Evidence: TAS. Frequency: Frequent (HP:0040282). (ORPHA:261552)
- Pointed chin (HP:0000307): A marked tapering of the lower face to the chin. Evidence: TAS. Frequency: Frequent (HP:0040282). (ORPHA:261552)
- Short philtrum (HP:0000322): Distance between nasal base and midline upper lip vermilion border more than 2 SD below the mean. Alternatively, an apparently decreased distance between nasal base and midline upper lip vermilion border. Evidence: TAS. Frequency: Frequent (HP:0040282). (ORPHA:261552)
- Posteriorly rotated ears (HP:0000358): A type of abnormal location of the ears in which the position of the ears is characterized by posterior rotation (the superior part of the ears is rotated towards the back of the head, and the inferior part of the ears towards the front). Evidence: TAS. Frequency: Frequent (HP:0040282). (ORPHA:261552)
- Recurrent otitis media (HP:0000403): Increased susceptibility to otitis media, as manifested by recurrent episodes of otitis media. Evidence: TAS. Frequency: Frequent (HP:0040282). (ORPHA:261552)
- Wide nasal bridge (HP:0000431): Increased breadth of the nasal bridge (and with it, the nasal root). Evidence: TAS. Frequency: Frequent (HP:0040282). (ORPHA:261552)
- Depressed nasal tip (HP:0000437): Decreased distance from the nasal tip to the nasal base. Evidence: TAS. Frequency: Frequent (HP:0040282). (ORPHA:261552)
- Convex nasal ridge (HP:0000444): Nasal ridge curving anteriorly to an imaginary line that connects the nasal root and tip. The nose appears often also prominent, and the columella low. Evidence: TAS. Frequency: Frequent (HP:0040282). (ORPHA:261552)
- Deeply set eye (HP:0000490): An eye that is more deeply recessed into the plane of the face than is typical. Evidence: TAS. Frequency: Frequent (HP:0040282). (ORPHA:261552)
- Telecanthus (HP:0000506): Distance between the inner canthi more than two standard deviations above the mean (objective); or, apparently increased distance between the inner canthi. Evidence: TAS. Frequency: Frequent (HP:0040282). (ORPHA:261552)
- Abnormality of the nervous system (HP:0000707): An abnormality of the nervous system. Evidence: TAS. Frequency: Frequent (HP:0040282). (ORPHA:261552)
- Motor stereotypy (HP:0000733): Use of the same abnormal action in response to certain triggers or at random. They may be used as a way to regulate one's internal state but must otherwise have no apparent functional purpose. Evidence: TAS. Frequency: Frequent (HP:0040282). (ORPHA:261552)
- Seizure (HP:0001250): A seizure is an intermittent abnormality of nervous system physiology characterized by a transient occurrence of signs and/or symptoms due to abnormal excessive or synchronous neuronal activity in the brain. Evidence: TAS. Frequency: Frequent (HP:0040282). (ORPHA:261552)
- Spasticity (HP:0001257): A motor disorder characterized by a velocity-dependent increase in tonic stretch reflexes with increased muscle tone, exaggerated (hyperexcitable) tendon reflexes. Evidence: TAS. Frequency: Frequent (HP:0040282). (ORPHA:261552)
- Abnormal corpus callosum morphology (HP:0001273): Abnormality of the corpus callosum. Evidence: TAS. Frequency: Frequent (HP:0040282). (ORPHA:261552)
- Agenesis of corpus callosum (HP:0001274): Absence of the corpus callosum as a result of the failure of the corpus callosum to develop, which can be the result of a failure in any one of the multiple steps of callosal development including cellular proliferation and migration, axonal growth or glial patterning at the midline. Evidence: TAS. Frequency: Frequent (HP:0040282). (ORPHA:261552)
- Failure to thrive (HP:0001508): Failure to thrive (FTT) refers to a child whose physical growth is substantially below the norm. Evidence: TAS. Frequency: Frequent (HP:0040282). (ORPHA:261552)
- Abnormal heart morphology (HP:0001627): Any structural anomaly of the heart. Evidence: TAS. Frequency: Frequent (HP:0040282). (ORPHA:261552)
- Hypoplasia of the corpus callosum (HP:0002079): Underdevelopment of the corpus callosum. Evidence: TAS. Frequency: Frequent (HP:0040282). (ORPHA:261552)
- Broad-based gait (HP:0002136): An abnormal gait pattern in which persons stand and walk with their feet spaced widely apart. This is often a component of cerebellar ataxia. Evidence: TAS. Frequency: Frequent (HP:0040282). (ORPHA:261552)
- Aganglionic megacolon (HP:0002251): An abnormality resulting from a lack of intestinal ganglion cells (i.e., an aganglionic section of bowel) that results in bowel obstruction with enlargement of the colon. Evidence: TAS. Frequency: Frequent (HP:0040282). (ORPHA:261552)
- EEG abnormality (HP:0002353): Abnormality observed by electroencephalogram (EEG), which is used to record of the brain's spontaneous electrical activity from multiple electrodes placed on the scalp. Evidence: TAS. Frequency: Frequent (HP:0040282). (ORPHA:261552)
- Sleep disturbance (HP:0002360): An abnormal pattern in the quality, quantity, or characteristics of sleep. Evidence: TAS. Frequency: Frequent (HP:0040282). (ORPHA:261552)
- Bowel incontinence (HP:0002607): Involuntary fecal soiling in adults and children who have usually already been toilet trained. Evidence: TAS. Frequency: Frequent (HP:0040282). (ORPHA:261552)
- Short stature (HP:0004322): A height below that which is expected according to age and gender norms. Although there is no universally accepted definition of short stature, many refer to "short stature" as height more than 2 standard deviations below the mean for age and gender (or below the 3rd percentile for age and gender dependent norms). Evidence: TAS. Frequency: Frequent (HP:0040282). (ORPHA:261552)
- Secondary microcephaly (HP:0005484): Head circumference which falls below 2 standard deviations below the mean for age and gender because of insufficient head growth after birth. Evidence: TAS. Frequency: Frequent (HP:0040282). (ORPHA:261552)
- Lateral ventricle dilatation (HP:0006956). Evidence: TAS. Frequency: Frequent (HP:0040282). (ORPHA:261552)
- Poor fine motor coordination (HP:0007010): An abnormality of the ability (skills) to perform a precise movement of small muscles with the intent to perform a specific act. Fine motor skills are required to mediate movements of the wrists, hands, fingers, feet, and toes. Evidence: TAS. Frequency: Frequent (HP:0040282). (ORPHA:261552)
- Atypical absence seizure (HP:0007270): An atypical absence seizure is a type of generalized non-motor (absence) seizure characterized by interruption of ongoing activities and reduced responsiveness. In comparison to a typical absence seizure, changes in tone may be more pronounced, onset and/or cessation may be less abrupt, and the duration of the ictus and post-ictal recovery may be longer. Although not always available, an EEG often demonstrates slow (<3 Hz), irregular, generalized spike-wave activity. Evidence: TAS. Frequency: Frequent (HP:0040282). (ORPHA:261552)
- Focal-onset seizure (HP:0007359): A focal-onset seizure is a type of seizure originating within networks limited to one hemisphere. They may be discretely localized or more widely distributed, and may originate in subcortical structures. Evidence: TAS. Frequency: Frequent (HP:0040282). (ORPHA:261552)
- Floppy infant (HP:0008947): Floppiness/hypotonia is defined as reduced resistance to passive movement of joints. Physical examination of floppy/hypotonic infants shows head lag, lack of shoulder and elbow muscle contraction on traction response, inability to tighten the shoulder girdle muscles (or slipping through) when held under the axillae, scarf sign (when the arm is pulled to the opposite side, the arm wraps around the neck with the elbow crossing midline), hyperdorsiflexion of the feet, easy apposition of the thumb against the forearm, feet touching the cheek with ease and without discomfort, frog leg position, and inverted U sign on ventral suspension (head, arms, and legs hanging down without elbow or knee flexion and the trunk rounded in a dome shape). Evidence: TAS. Frequency: Frequent (HP:0040282). (ORPHA:261552)
- Low hanging columella (HP:0009765): Columella extending inferior to the level of the nasal base, when viewed from the side. Evidence: TAS. Frequency: Frequent (HP:0040282). (ORPHA:261552)
- Uplifted earlobe (HP:0009909): An abnormal orientation of the earlobes such that they point out- and upward. That is, the lateral surface of ear lobe faces superiorly. Evidence: TAS. Frequency: Frequent (HP:0040282). (ORPHA:261552)
- Broad eyebrow (HP:0011229): Regional increase in the width (height) of the eyebrow. Evidence: TAS. Frequency: Frequent (HP:0040282). (ORPHA:261552)
- Abnormal hippocampus morphology (HP:0025100): Any structural anomaly of the hippocampus,. Evidence: TAS. Frequency: Frequent (HP:0040282). (ORPHA:261552)
- Hypoplastic anterior commissure (HP:0030303): Underdevelopment of the anterior commissure. Evidence: TAS. Frequency: Frequent (HP:0040282). (ORPHA:261552)
- Delayed ability to walk (HP:0031936): A failure to achieve the ability to walk at an appropriate developmental stage. Most children learn to walk in a series of stages, and learn to walk short distances independently between 12 and 15 months. Evidence: TAS. Frequency: Frequent (HP:0040282). (ORPHA:261552)
- Multicystic kidney dysplasia (HP:0000003): Multicystic dysplasia of the kidney is characterized by multiple cysts of varying size in the kidney and the absence of a normal pelvicaliceal system. The condition is associated with ureteral or ureteropelvic atresia, and the affected kidney is nonfunctional. Evidence: TAS. Frequency: Occasional (HP:0040283). (ORPHA:261552)
- Renal duplication (HP:0000075): A congenital anomaly of the urinary tract, in which the kidney is duplicated and is drained via two separate renal pelves and ureters. Evidence: TAS. Frequency: Occasional (HP:0040283). (ORPHA:261552)
- Vesicoureteral reflux (HP:0000076): Abnormal (retrograde) movement of urine from the bladder into ureters or kidneys related to inadequacy of the valvular mechanism at the ureterovesicular junction or other causes. Evidence: TAS. Frequency: Occasional (HP:0040283). (ORPHA:261552)
- Pelvic kidney (HP:0000125): A developmental defect in which a kidney is located in an abnormal anatomic position within the pelvis. Evidence: TAS. Frequency: Occasional (HP:0040283). (ORPHA:261552)
- Hydronephrosis (HP:0000126): Severe distention of the kidney with dilation of the renal pelvis and calices. Evidence: TAS. Frequency: Occasional (HP:0040283). (ORPHA:261552)
- Gingival overgrowth (HP:0000212): Hyperplasia of the gingiva (that is, a thickening of the soft tissue overlying the alveolar ridge. The degree of thickening ranges from involvement of the interdental papillae alone to gingival overgrowth covering the entire tooth crown. Evidence: TAS. Frequency: Occasional (HP:0040283). (ORPHA:261552)
- Hypertelorism (HP:0000316): Interpupillary distance more than 2 SD above the mean (alternatively, the appearance of an increased interpupillary distance or widely spaced eyes). Evidence: TAS. Frequency: Occasional (HP:0040283). (ORPHA:261552)
- Abnormality of the eye (HP:0000478): Any abnormality of the eye, including location, spacing, and intraocular abnormalities. Evidence: TAS. Frequency: Occasional (HP:0040283). (ORPHA:261552)
- Retinal coloboma (HP:0000480): A notch or cleft of the retina or choroid, located vertically below the optic disc. Evidence: TAS. Frequency: Occasional (HP:0040283). (ORPHA:261552)
- Microcornea (HP:0000482): A congenital abnormality of the cornea in which the cornea and the anterior segment of the eye are smaller than normal. The horizontal diameter of the cornea does not reach 10 mm even in adulthood. Evidence: TAS. Frequency: Occasional (HP:0040283). (ORPHA:261552)
- Astigmatism (HP:0000483): A type of refraction error associated with abnormal curvatures on the anterior and/or posterior surface of the cornea. Evidence: TAS. Frequency: Occasional (HP:0040283). (ORPHA:261552)
- Strabismus (HP:0000486): A misalignment of the eyes so that the visual axes deviate from bifoveal fixation. The classification of strabismus may be based on a number of features including the relative position of the eyes, whether the deviation is latent or manifest, intermittent or constant, concomitant or otherwise and according to the age of onset and the relevance of any associated refractive error. Evidence: TAS. Frequency: Occasional (HP:0040283). (ORPHA:261552)
- Visual impairment (HP:0000505): Visual impairment (or vision impairment) is vision loss (of a person) to such a degree as to qualify as an additional support need through a significant limitation of visual capability resulting from either disease, trauma, or congenital or degenerative conditions that cannot be corrected by conventional means, such as refractive correction, medication, or surgery. Evidence: TAS. Frequency: Occasional (HP:0040283). (ORPHA:261552)
- Ptosis (HP:0000508): The upper eyelid margin is positioned 3 mm or more lower than usual and covers the superior portion of the iris (objective); or, the upper lid margin obscures at least part of the pupil (subjective). Evidence: TAS. Frequency: Occasional (HP:0040283). (ORPHA:261552)
- Cataract (HP:0000518): A cataract is an opacity or clouding that develops in the crystalline lens of the eye or in its capsule. Evidence: TAS. Frequency: Occasional (HP:0040283). (ORPHA:261552)
- Abnormality of refraction (HP:0000539): An abnormality in the process of focusing of light by the eye in order to produce a sharp image on the retina. Evidence: TAS. Frequency: Occasional (HP:0040283). (ORPHA:261552)
- Myopia (HP:0000545): An abnormality of refraction characterized by the ability to see objects nearby clearly, while objects in the distance appear blurry. Evidence: TAS. Frequency: Occasional (HP:0040283). (ORPHA:261552)
- Microphthalmia (HP:0000568): A developmental anomaly characterized by abnormal smallness of one or both eyes. Evidence: TAS. Frequency: Occasional (HP:0040283). (ORPHA:261552)
- Iris coloboma (HP:0000612): A coloboma of the iris. Evidence: TAS. Frequency: Occasional (HP:0040283). (ORPHA:261552)
- Abnormal pupil morphology (HP:0000615): An abnormality of the pupil. Evidence: TAS. Frequency: Occasional (HP:0040283). (ORPHA:261552)
- Optic atrophy (HP:0000648): Atrophy of the optic nerve. Optic atrophy results from the death of the retinal ganglion cell axons that comprise the optic nerve and manifesting as a pale optic nerve on fundoscopy. Evidence: TAS. Frequency: Occasional (HP:0040283). (ORPHA:261552)
- Dental crowding (HP:0000678): Changes in alignment of teeth in the dental arch. Evidence: TAS. Frequency: Occasional (HP:0040283). (ORPHA:261552)
- Delayed eruption of teeth (HP:0000684): Delayed tooth eruption, which can be defined as tooth eruption more than 2 SD beyond the mean eruption age. Evidence: TAS. Frequency: Occasional (HP:0040283). (ORPHA:261552)
- Tooth malposition (HP:0000692): Abnormal alignment, positioning, or spacing of the teeth, i.e., misaligned teeth. Evidence: TAS. Frequency: Occasional (HP:0040283). (ORPHA:261552)
- Pectus excavatum (HP:0000767): A defect of the chest wall characterized by a depression of the sternum, giving the chest ("pectus") a caved-in ("excavatum") appearance. Evidence: TAS. Frequency: Occasional (HP:0040283). (ORPHA:261552)
- Pectus carinatum (HP:0000768): A deformity of the chest caused by overgrowth of the ribs and characterized by protrusion of the sternum. Evidence: TAS. Frequency: Occasional (HP:0040283). (ORPHA:261552)
- Abnormal posterior cranial fossa morphology (HP:0000932): An abnormality of the fossa cranii posterior (the posterior fossa), which is made up primarily of the occipital bone and which surrounds to the foramen magnum. Evidence: TAS. Frequency: Occasional (HP:0040283). (ORPHA:261552)
- Iris atrophy (HP:0001089): Loss of iris tissue (atrophy). Evidence: TAS. Frequency: Occasional (HP:0040283). (ORPHA:261552)
- Syndactyly (HP:0001159): Webbing or fusion of the fingers or toes, involving soft parts only or including bone structure. Bony fusions are referred to as "bony" syndactyly if the fusion occurs in a radio-ulnar axis. Fusions of bones of the fingers or toes in a proximo-distal axis are referred to as "symphalangism". Evidence: TAS. Frequency: Occasional (HP:0040283). (ORPHA:261552)
- Arachnodactyly (HP:0001166): Abnormally long and slender fingers (spider fingers). Evidence: TAS. Frequency: Occasional (HP:0040283). (ORPHA:261552)
- Adducted thumb (HP:0001181): In the resting position, the tip of the thumb is on, or near, the palm, close to the base of the fourth or fifth finger. Evidence: TAS. Frequency: Occasional (HP:0040283). (ORPHA:261552)
- Hyperreflexia (HP:0001347): Hyperreflexia is the presence of hyperactive stretch reflexes of the muscles. Evidence: TAS. Frequency: Occasional (HP:0040283). (ORPHA:261552)
- Flexion contracture (HP:0001371): A flexion contracture is a bent (flexed) joint that cannot be straightened actively or passively. It is thus a chronic loss of joint motion due to structural changes in muscle, tendons, ligaments, or skin that prevents normal movement of joints. Evidence: TAS. Frequency: Occasional (HP:0040283). (ORPHA:261552)
- Axenfeld anomaly (HP:0001492): Axenfeld's anomaly is a bilateral disorder characterized by a prominent, anteriorly displaced Schwalbe's line (posterior embryotoxon) and peripheral iris strands which span the anterior chamber angle to attach to Schwalbe's line. Evidence: TAS. Frequency: Occasional (HP:0040283). (ORPHA:261552)
- Tetralogy of Fallot (HP:0001636): A congenital cardiac malformation comprising pulmonary stenosis, overriding aorta, ventricular septum defect, and right ventricular hypertrophy. The diagnosis of TOF is made if at least three of the four above mentioned features are present. Evidence: TAS. Frequency: Occasional (HP:0040283). (ORPHA:261552)
- Abnormal pulmonary valve morphology (HP:0001641): Any structural abnormality of the pulmonary valve. Evidence: TAS. Frequency: Occasional (HP:0040283). (ORPHA:261552)
- Pulmonic stenosis (HP:0001642): A narrowing of the right ventricular outflow tract that can occur at the pulmonary valve (valvular stenosis), below the pulmonary valve (infundibular stenosis), or above the pulmonary valve (supravalvar stenosis). Evidence: TAS. Frequency: Occasional (HP:0040283). (ORPHA:261552)
- Bicuspid aortic valve (HP:0001647): The presence of an aortic valve with two instead of the normal three cusps (flaps). Bicuspid aortic valvue is a malformation of a commissure (small space between the attachment of each cusp to the aortic wall) and the adjacent parts of the two corresponding cusps forming a raphe (the fused area of the two underdeveloped cusps turning into a malformed commissure between both cusps; the raphe is a fibrous ridge that extends from the commissure to the free edge of the two underdeveloped, conjoint cusps). Evidence: TAS. Frequency: Occasional (HP:0040283). (ORPHA:261552)
- Aortic valve stenosis (HP:0001650): The presence of a stenosis (narrowing) of the aortic valve. Evidence: TAS. Frequency: Occasional (HP:0040283). (ORPHA:261552)
- Coarctation of aorta (HP:0001680): Coarctation of the aorta is a narrowing or constriction of a segment of the aorta. Evidence: TAS. Frequency: Occasional (HP:0040283). (ORPHA:261552)
- Asplenia (HP:0001746): Absence (aplasia) of the spleen. Evidence: TAS. Frequency: Occasional (HP:0040283). (ORPHA:261552)
- Pes planus (HP:0001763): A foot where the longitudinal arch of the foot is in contact with the ground or floor when the individual is standing; or, in a patient lying supine, a foot where the arch is in contact with the surface of a flat board pressed against the sole of the foot by the examiner with a pressure similar to that expected from weight bearing; or, the height of the arch is reduced. Evidence: TAS. Frequency: Occasional (HP:0040283). (ORPHA:261552)
- Hallux valgus (HP:0001822): Lateral deviation of the great toe (i.e., in the direction of the little toe). Evidence: TAS. Frequency: Occasional (HP:0040283). (ORPHA:261552)
- Long hallux (HP:0001847): Increased length of the big toe. Evidence: TAS. Frequency: Occasional (HP:0040283). (ORPHA:261552)
- Calcaneovalgus deformity (HP:0001848): This is a postural deformity in which the foot is positioned up against the tibia. The heel (calcaneus) is positioned downward (that is, the ankle is flexed upward), and the heel is turned outward (valgus). Evidence: TAS. Frequency: Occasional (HP:0040283). (ORPHA:261552)
- Frontal bossing (HP:0002007): Bilateral bulging of the lateral frontal bone prominences with relative sparing of the midline. Evidence: TAS. Frequency: Occasional (HP:0040283). (ORPHA:261552)
- Constipation (HP:0002019): Infrequent or difficult evacuation of feces. Evidence: TAS. Frequency: Occasional (HP:0040283). (ORPHA:261552)
- Pyloric stenosis (HP:0002021): Pyloric stenosis, also known as infantile hypertrophic pyloric stenosis, is an uncommon condition in infants characterized by abnormal thickening of the pylorus muscles in the stomach leading to gastric outlet obstruction. Clinically infants are well at birth. Then, at 3 to 6 weeks of age, the infants present with projectile vomiting, potentially leading to dehydration and weight loss. Evidence: TAS. Frequency: Occasional (HP:0040283). (ORPHA:261552)
- Inability to walk (HP:0002540): Incapability to ambulate. Evidence: TAS. Frequency: Occasional (HP:0040283). (ORPHA:261552)
- Episodic vomiting (HP:0002572): Paroxysmal, recurrent episodes of vomiting. Evidence: TAS. Frequency: Occasional (HP:0040283). (ORPHA:261552)
- Scoliosis (HP:0002650): The presence of an abnormal lateral curvature of the spine. Evidence: TAS. Frequency: Occasional (HP:0040283). (ORPHA:261552)
- Recurrent infections (HP:0002719): Increased susceptibility to infections as manifested by repeated bouts of infection. Evidence: TAS. Frequency: Occasional (HP:0040283). (ORPHA:261552)
- Delayed skeletal maturation (HP:0002750): A decreased rate of skeletal maturation. Delayed skeletal maturation can be diagnosed on the basis of an estimation of the bone age from radiographs of specific bones in the human body. Evidence: TAS. Frequency: Occasional (HP:0040283). (ORPHA:261552)
- Genu valgum (HP:0002857): The legs angle inward, such that the knees are close together and the ankles far apart. Evidence: TAS. Frequency: Occasional (HP:0040283). (ORPHA:261552)
- Bruxism (HP:0003763): Bruxism is characterized by the grinding of the teeth including the clenching of the jaw and typically occur during sleep. Evidence: TAS. Frequency: Occasional (HP:0040283). (ORPHA:261552)
- Decreased circulating immunoglobulin concentration (HP:0004313): An abnormally decreased level of immunoglobulin in blood. Evidence: TAS. Frequency: Occasional (HP:0040283). (ORPHA:261552)
- Abnormality of the pulmonary artery (HP:0004414): An abnormality of the pulmonary artery. Evidence: TAS. Frequency: Occasional (HP:0040283). (ORPHA:261552)
- Abnormal dental morphology (HP:0006482): An abnormality of the morphology of the tooth. Evidence: TAS. Frequency: Occasional (HP:0040283). (ORPHA:261552)
- Large basal ganglia (HP:0007048): Increased size of the basal ganglia. Evidence: TAS. Frequency: Occasional (HP:0040283). (ORPHA:261552)
- Impaired pain sensation (HP:0007328): Reduced ability to perceive painful stimuli. Evidence: TAS. Frequency: Occasional (HP:0040283). (ORPHA:261552)
- Ulnar deviation of the hand (HP:0009487): Divergence of the longitudinal axis of the hand at the wrist in a posterior (ulnar) direction (i.e., towards the little finger). Evidence: TAS. Frequency: Occasional (HP:0040283). (ORPHA:261552)
- Ectopia pupillae (HP:0009918): A malposition of the pupil owing to a developmental defect of the iris. Evidence: TAS. Frequency: Occasional (HP:0040283). (ORPHA:261552)
- Broad hallux (HP:0010055): Visible increase in width of the hallux without an increase in the dorso-ventral dimension. Evidence: TAS. Frequency: Occasional (HP:0040283). (ORPHA:261552)
- Long toe (HP:0010511): Toes that appear disproportionately long compared to the foot. Evidence: TAS. Frequency: Occasional (HP:0040283). (ORPHA:261552)
- Primary microcephaly (HP:0011451): Head circumference below 2 standard deviations below the mean for age and gender at birth. Evidence: TAS. Frequency: Occasional (HP:0040283). (ORPHA:261552)
- Camptodactyly (HP:0012385): The distal interphalangeal joint and/or the proximal interphalangeal joint of the fingers or toes cannot be extended to 180 degrees by either active or passive extension. Evidence: TAS. Frequency: Occasional (HP:0040283). (ORPHA:261552)
- Cerebral white matter hypoplasia (HP:0012430): Underdevelopment of the cerebral white matter. Evidence: TAS. Frequency: Occasional (HP:0040283). (ORPHA:261552)
- Abnormal jaw morphology (HP:0030791): A structural anomaly of the jaw, the bony structure of the mouth that consists of the mandible and the maxilla. Evidence: TAS. Frequency: Occasional (HP:0040283). (ORPHA:261552)
- Focal hypointensity of cerebral white matter on MRI (HP:0040331). Evidence: TAS. Frequency: Occasional (HP:0040283). (ORPHA:261552)
- Hydrocele testis (HP:0000034): Accumulation of clear fluid in the between the layers of membrane (tunica vaginalis) surrounding the testis. Evidence: TAS. Frequency: Very rare (HP:0040284). (ORPHA:261552)
- Chordee (HP:0000041): A congenital anomaly of the penis characterized by ventral (i.e., downward), lateral, or ventrolateral curvature of the shaft and glans penis of more than 30 degrees. Evidence: TAS. Frequency: Very rare (HP:0040284). (ORPHA:261552)
- Bifid scrotum (HP:0000048): Midline indentation or cleft of the scrotum. Evidence: TAS. Frequency: Very rare (HP:0040284). (ORPHA:261552)
- Micropenis (HP:0000054): Abnormally small penis. At birth, the normal penis is about 3 cm (stretched length from pubic tubercle to tip of penis) with micropenis less than 2.0-2.5 cm. Evidence: TAS. Frequency: Very rare (HP:0040284). (ORPHA:261552)
- Cleft palate (HP:0000175): Cleft palate is a developmental defect of the palate resulting from a failure of fusion of the palatine processes and manifesting as a separation of the roof of the mouth (soft and hard palate). Evidence: TAS. Frequency: Very rare (HP:0040284). (ORPHA:261552)
- Bifid uvula (HP:0000193): Uvula separated into two parts most easily seen at the tip. Evidence: TAS. Frequency: Very rare (HP:0040284). (ORPHA:261552)
- Epicanthus (HP:0000286): A fold of skin starting above the medial aspect of the upper eyelid and arching downward to cover, pass in front of and lateral to the medial canthus. Evidence: TAS. Frequency: Very rare (HP:0040284). (ORPHA:261552)
- Sensorineural hearing impairment (HP:0000407): A type of hearing impairment in one or both ears related to an abnormal functionality of the cochlear nerve. Evidence: TAS. Frequency: Very rare (HP:0040284). (ORPHA:261552)
- Septate vagina (HP:0001153): The presence of a vaginal septum, thereby creating a vaginal duplication. The septum is longitudinal in the majority of cases. Evidence: TAS. Frequency: Very rare (HP:0040284). (ORPHA:261552)
- Cerebellar vermis hypoplasia (HP:0001320): Underdevelopment of the vermis of cerebellum. Evidence: TAS. Frequency: Very rare (HP:0040284). (ORPHA:261552)
- Cerebellar hypoplasia (HP:0001321): Cerebellar hypoplasia is a descriptive term implying a cerebellum with a reduced volume, but a normal shape and is stable over time. Evidence: TAS. Frequency: Very rare (HP:0040284). (ORPHA:261552)
- Ventricular septal defect (HP:0001629): A hole between the two bottom chambers (ventricles) of the heart. The defect is centered around the most superior aspect of the ventricular septum. Evidence: TAS. Frequency: Very rare (HP:0040284). (ORPHA:261552)
- Patent ductus arteriosus (HP:0001643): In utero, the ductus arteriosus (DA) serves to divert ventricular output away from the lungs and toward the placenta by connecting the main pulmonary artery to the descending aorta. A patent ductus arteriosus (PDA) in the first 3 days of life is a physiologic shunt in healthy term and preterm newborn infants, and normally is substantially closed within about 24 hours after bith and completely closed after about three weeks. Failure of physiologcal closure is referred to a persistent or patent ductus arteriosus (PDA). Depending on the degree of left-to-right shunting, PDA can have clinical consequences. Evidence: TAS. Frequency: Very rare (HP:0040284). (ORPHA:261552)
- Dysphagia (HP:0002015): Difficulty in swallowing. Evidence: TAS. Frequency: Very rare (HP:0040284). (ORPHA:261552)
- Polymicrogyria (HP:0002126): Polymicrogyria is a congenital malformation of the cerebral cortex characterized by abnormal cortical layering (lamination) and an excessive number of small gyri (folds). Evidence: TAS. Frequency: Very rare (HP:0040284). (ORPHA:261552)
- Agenesis of cerebellar vermis (HP:0002335): Congenital absence of the vermis of cerebellum. Evidence: TAS. Frequency: Very rare (HP:0040284). (ORPHA:261552)
- Poor speech (HP:0002465). Evidence: TAS. Frequency: Very rare (HP:0040284). (ORPHA:261552)
- Highly arched eyebrow (HP:0002553): Increased height of the central portion of the eyebrow, forming a crescent, semicircular, or inverted U shape. Evidence: TAS. Frequency: Very rare (HP:0040284). (ORPHA:261552)
- Tracheal stenosis (HP:0002777). Evidence: TAS. Frequency: Very rare (HP:0040284). (ORPHA:261552)
- Pulmonary artery sling (HP:0004961): An anomalous origin of the left pulmonary artery, such that it arises from the posterior aspect of the right pulmonary artery and passes between the trachea and esophagus to reach the left hilum. Evidence: TAS. Frequency: Very rare (HP:0040284). (ORPHA:261552)
- Duplication of renal pelvis (HP:0005580): A duplication of the renal pelvis. Evidence: TAS. Frequency: Very rare (HP:0040284). (ORPHA:261552)
- Chiari type I malformation (HP:0007099): Arnold-Chiari type I malformation refers to a relatively mild degree of herniation of the posteroinferior region of the cerebellum (the cerebellar tonsils) into the cervical canal with little or no displacement of the fourth ventricle. It is characterized by one or both pointed (not rounded) cerebellar tonsils that project 5 mm below the foramen magnum, measured by a line drawn from the basion to the opisthion (McRae Line). Evidence: TAS. Frequency: Very rare (HP:0040284). (ORPHA:261552)
- Periventricular heterotopia (HP:0007165): A form of gray matter heterotopia were the mislocalized gray matter is typically located periventricularly, also sometimes called subependymal heterotopia. Periventricular means beside the ventricles. This is by far the most common location for heterotopia. Subependymal heterotopia present in a wide array of variations. There can be a small single node or a large number of nodes, can exist on either or both sides of the brain at any point along the higher ventricle margins, can be small or large, single or multiple, and can form a small node or a large wavy or curved mass. Evidence: TAS. Frequency: Very rare (HP:0040284). (ORPHA:261552)
- Concave nasal ridge (HP:0011120): Nasal ridge curving posteriorly to an imaginary line that connects the nasal root and tip. Evidence: TAS. Frequency: Very rare (HP:0040284). (ORPHA:261552)
- Right unicoronal synostosis (HP:0011317): Unicoronal synostosis affecting only the right coronal suture. Evidence: TAS. Frequency: Very rare (HP:0040284). (ORPHA:261552)
- Hyphema (HP:0011886): Bleeding in the anterior chamber of the eye. Evidence: TAS. Frequency: Very rare (HP:0040284). (ORPHA:261552)
- Enlarged cerebellum (HP:0012081): An abnormally increased size of the cerebellum compared to other brain structures. Evidence: TAS. Frequency: Very rare (HP:0040284). (ORPHA:261552)
- Webbed penis (HP:0030264): Ventral skinfold extending from penis to scrotum. Evidence: TAS. Frequency: Very rare (HP:0040284). (ORPHA:261552)
- Cleft hard palate (HP:0410005). Evidence: TAS. Frequency: Very rare (HP:0040284). (ORPHA:261552)
- Submucous cleft of soft and hard palate (HP:0410031): Soft and hard-palate submucous clefts are characterized by bony defects in the midline of the soft and hard palate that are covered by the lining (ie mucous membrane) of the roof of the mouth. Evidence: TAS. Frequency: Very rare (HP:0040284). (ORPHA:261552)